Phenotypes associated with the disease diffuse panbronchiolitis (OMIM:604809):
- Progressive (HP:0003676): Applies to a disease manifestation that increases in scope or severity over the course of time, i.e., that worsens with age. Evidence: TAS. (OMIM:604809)
- Rhonchi (HP:0030831): Abnormal breath sounds characterized by low-pitched, snoring or rattle-like sounds. Evidence: TAS. (OMIM:604809)
- Crackles (HP:0030830): Crackles are discontinuous, explosive, and nonmusical adventitious lung sounds normally heard in inspiration and sometimes during expiration. Crackles are usually classified as fine and coarse crackles based on their duration, loudness, pitch, timing in the respiratory cycle, and relationship to coughing and changing body position. Evidence: TAS. (OMIM:604809)
- Foam cells (HP:0003651): The presence of foam cells, a type of macrophage that localizes to fatty deposits on blood vessel walls, where they ingest low-density lipoproteins and become laden with lipids, giving them a foamy appearance. Evidence: TAS. (OMIM:604809)
- Bronchiectasis (HP:0002110): Persistent abnormal dilatation of the bronchi owing to localized and irreversible destruction and widening of the large airways. Evidence: TAS. (OMIM:604809)
- Cough (HP:0012735): A sudden, audible expulsion of air from the lungs through a partially closed glottis, preceded by inhalation. Evidence: TAS. (OMIM:604809)
- Wheezing (HP:0030828): A high-pitched whistling sound associated with labored breathing. Evidence: TAS. (OMIM:604809)
- Hypoxemia (HP:0012418): An abnormally low level of blood oxygen. Evidence: TAS. (OMIM:604809)